Phenotypes associated with the disease Microphthalmia, Lenz type (ORPHA:568):
- Abnormal pinna morphology (HP:0000377): An abnormality of the pinna, which is also referred to as the auricle or external ear. Evidence: TAS. Frequency: Frequent (HP:0040282). (ORPHA:568)
- Posteriorly rotated ears (HP:0000358): A type of abnormal location of the ears in which the position of the ears is characterized by posterior rotation (the superior part of the ears is rotated towards the back of the head, and the inferior part of the ears towards the front). Evidence: TAS. Frequency: Frequent (HP:0040282). (ORPHA:568)
- Microphthalmia (HP:0000568): A developmental anomaly characterized by abnormal smallness of one or both eyes. Evidence: TAS. Frequency: Very frequent (HP:0040281). (ORPHA:568)
- Cryptorchidism (HP:0000028): Testis in inguinal canal. That is, absence of one or both testes from the scrotum owing to failure of the testis or testes to descend through the inguinal canal to the scrotum. Evidence: TAS. Frequency: Frequent (HP:0040282). (ORPHA:568)
- Hypospadias (HP:0000047): Abnormal position of urethral meatus on the ventral penile shaft (underside) characterized by displacement of the urethral meatus from the tip of the glans penis to the ventral surface of the penis, scrotum, or perineum. Evidence: TAS. Frequency: Frequent (HP:0040282). (ORPHA:568)
- Hydroureter (HP:0000072): The distention of the ureter with urine. Evidence: TAS. Frequency: Frequent (HP:0040282). (ORPHA:568)
- Hydronephrosis (HP:0000126): Severe distention of the kidney with dilation of the renal pelvis and calices. Evidence: TAS. Frequency: Frequent (HP:0040282). (ORPHA:568)
- Abnormality of the dentition (HP:0000164): Any abnormality of the teeth. Evidence: TAS. Frequency: Frequent (HP:0040282). (ORPHA:568)
- Orofacial cleft (HP:0000202): The presence of a cleft (gap, opening, or groove) in the oral cavity, including cleft of the upper lip and/or cleft of the palate. Cleft of the upper lip is visible as a groove or fissure in the lip, most frequently due to a congenital failure of the maxillary and median nasal processes to fuse. Cleft palate is characterized by a grooved depression or fissure in the roof of the mouth, most often resulting from a congenital failure of the palate to fuse properly. Clefts of the lip and palate can occur individually or together. It is preferable to code each defect separately. Evidence: TAS. Frequency: Frequent (HP:0040282). (ORPHA:568)
- Microcephaly (HP:0000252): Head circumference below 2 standard deviations below the mean for age and gender. Evidence: TAS. Frequency: Frequent (HP:0040282). (ORPHA:568)
- Microcornea (HP:0000482): A congenital abnormality of the cornea in which the cornea and the anterior segment of the eye are smaller than normal. The horizontal diameter of the cornea does not reach 10 mm even in adulthood. Evidence: TAS. Frequency: Frequent (HP:0040282). (ORPHA:568)
- Glaucoma (HP:0000501): Glaucoma refers loss of retinal ganglion cells in a characteristic pattern of optic neuropathy usually associated with increased intraocular pressure. Evidence: TAS. Frequency: Frequent (HP:0040282). (ORPHA:568)
- Chorioretinal coloboma (HP:0000567): Absence of a region of the retina, retinal pigment epithelium, and choroid. Evidence: TAS. Frequency: Frequent (HP:0040282). (ORPHA:568)
- Optic disc coloboma (HP:0000588): A cleft of the optic nerve that extends inferiorly. Evidence: TAS. Frequency: Frequent (HP:0040282). (ORPHA:568)
- Iris coloboma (HP:0000612): A coloboma of the iris. Evidence: TAS. Frequency: Frequent (HP:0040282). (ORPHA:568)
- Intellectual disability (HP:0001249): The term intellectual disability or intellectual developmental disorder is used to describe significantly sub-average intellectual and adaptive functioning based on clinical assessment and as measured by individually administered, appropriately normed, standardized and validated tests of intellectual functioning and adaptive behavior, with onset during the developmental period from infancy through adolescence. Evidence: TAS. Frequency: Frequent (HP:0040282). (ORPHA:568)
- Clinodactyly of the 5th finger (HP:0004209): Clinodactyly refers to a bending or curvature of the fifth finger in the radial direction (i.e., towards the 4th finger). Evidence: TAS. Frequency: Frequent (HP:0040282). (ORPHA:568)
- Short stature (HP:0004322): A height below that which is expected according to age and gender norms. Although there is no universally accepted definition of short stature, many refer to "short stature" as height more than 2 standard deviations below the mean for age and gender (or below the 3rd percentile for age and gender dependent norms). Evidence: TAS. Frequency: Frequent (HP:0040282). (ORPHA:568)
- Finger syndactyly (HP:0006101): Webbing or fusion of the fingers, involving soft parts only or including bone structure. Bony fusions are referred to as "bony" Syndactyly if the fusion occurs in a radio-ulnar axis. Fusions of bones of the fingers in a proximo-distal axis are referred to as "Symphalangism". Evidence: TAS. Frequency: Frequent (HP:0040282). (ORPHA:568)
- Abnormal dental morphology (HP:0006482): An abnormality of the morphology of the tooth. Evidence: TAS. Frequency: Frequent (HP:0040282). (ORPHA:568)
- Renal hypoplasia/aplasia (HP:0008678): Absence or underdevelopment of the kidney. Evidence: TAS. Frequency: Frequent (HP:0040282). (ORPHA:568)
- Complete duplication of thumb phalanx (HP:0009943): A complete duplication affecting one or more of the phalanges of the thumb. As opposed to a partial duplication were there is still a variable degree of fusion between the duplicated bones, a complete duplication leads to two separate bones appearing side to side (radio-ulnar axis) as seen on x-rays. A duplication leading to an accessory bone appearing in the proximo-distal axis on x-rays, this is actually a different entity called a Pseudoepiphyses (see according terms) sometimes also referred to as Hyperphalangism. Evidence: TAS. Frequency: Frequent (HP:0040282). (ORPHA:568)
- Camptodactyly of finger (HP:0100490): The distal interphalangeal joint and/or the proximal interphalangeal joint of the fingers cannot be extended to 180 degrees by either active or passive extension. Evidence: TAS. Frequency: Frequent (HP:0040282). (ORPHA:568)
- Hearing impairment (HP:0000365): A decreased magnitude of the sensory perception of sound. Evidence: TAS. Frequency: Occasional (HP:0040283). (ORPHA:568)
- Preauricular skin tag (HP:0000384): A rudimentary tag of skin often containing ear tissue including a core of cartilage and located just anterior to the auricle (outer part of the ear). Evidence: TAS. Frequency: Occasional (HP:0040283). (ORPHA:568)
- Webbed neck (HP:0000465): Pterygium colli is a congenital skin fold that runs along the sides of the neck down to the shoulders. It involves an ectopic fibrotic facial band superficial to the trapezius muscle. Excess hair-bearing skin is also present and extends down the cervical region well beyond the normal hairline. Evidence: TAS. Frequency: Occasional (HP:0040283). (ORPHA:568)
- Visual impairment (HP:0000505): Visual impairment (or vision impairment) is vision loss (of a person) to such a degree as to qualify as an additional support need through a significant limitation of visual capability resulting from either disease, trauma, or congenital or degenerative conditions that cannot be corrected by conventional means, such as refractive correction, medication, or surgery. Evidence: TAS. Frequency: Occasional (HP:0040283). (ORPHA:568)
- Cataract (HP:0000518): A cataract is an opacity or clouding that develops in the crystalline lens of the eye or in its capsule. Evidence: TAS. Frequency: Occasional (HP:0040283). (ORPHA:568)
- Nystagmus (HP:0000639): Rhythmic, involuntary oscillations of one or both eyes related to abnormality in fixation, conjugate gaze, or vestibular mechanisms. Evidence: TAS. Frequency: Occasional (HP:0040283). (ORPHA:568)
- Delayed eruption of teeth (HP:0000684): Delayed tooth eruption, which can be defined as tooth eruption more than 2 SD beyond the mean eruption age. Evidence: TAS. Frequency: Occasional (HP:0040283). (ORPHA:568)
- Abnormal clavicle morphology (HP:0000889): Any abnormality of the clavicles (collar bones). Evidence: TAS. Frequency: Occasional (HP:0040283). (ORPHA:568)
- Seizure (HP:0001250): A seizure is an intermittent abnormality of nervous system physiology characterized by a transient occurrence of signs and/or symptoms due to abnormal excessive or synchronous neuronal activity in the brain. Evidence: TAS. Frequency: Occasional (HP:0040283). (ORPHA:568)
- Abnormal speech pattern (HP:0002167): An abnormality in the sound (volume) or cadence (rate) of speech. Evidence: TAS. Frequency: Occasional (HP:0040283). (ORPHA:568)
- Scoliosis (HP:0002650): The presence of an abnormal lateral curvature of the spine. Evidence: TAS. Frequency: Occasional (HP:0040283). (ORPHA:568)
- Kyphosis (HP:0002808): Exaggerated anterior convexity of the thoracic vertebral column. Evidence: TAS. Frequency: Occasional (HP:0040283). (ORPHA:568)
- Abnormal shoulder morphology (HP:0003043): An abnormality of the shoulder, which is defined as the structures surrounding the shoulder joint where the humerus attaches to the scapula. Evidence: TAS. Frequency: Occasional (HP:0040283). (ORPHA:568)
- Hyperlordosis (HP:0003307): Abnormally increased curvature (anterior concavity) of the lumbar or cervical spine. Evidence: TAS. Frequency: Occasional (HP:0040283). (ORPHA:568)
- Aplasia/Hypoplasia of the corpus callosum (HP:0007370): Absence or underdevelopment of the corpus callosum. Evidence: TAS. Frequency: Occasional (HP:0040283). (ORPHA:568)
- Ankyloblepharon (HP:0009755): Partial fusion of the upper and lower eyelid margins by single or multiple bands of tissue. Evidence: TAS. Frequency: Occasional (HP:0040283). (ORPHA:568)
- Abnormal cardiovascular system morphology (HP:0030680): Any structural anomaly of the heart and blood vessels. Evidence: TAS. Frequency: Occasional (HP:0040283). (ORPHA:568)
- Self-injurious behavior (HP:0100716): Self-aggression. Evidence: TAS. Frequency: Occasional (HP:0040283). (ORPHA:568)
- Long thorax (HP:0100818): Increased inferior to superior extent of the thorax. Evidence: TAS. Frequency: Occasional (HP:0040283). (ORPHA:568)